Phenotypes associated with the disease Leigh syndrome, mitochondrial (OMIM:500017):
- Focal T2 hyperintense basal ganglia lesion (HP:0007183): A lighter than expected T2 signal on magnetic resonance imaging (MRI) of the basal ganglia. This term refers to a localized hyperintensity affecting a particular region of the basal ganglia. Evidence: TAS. (OMIM:500017)
- Developmental regression (HP:0002376): Loss of developmental skills, as manifested by loss of developmental milestones. Evidence: TAS. (OMIM:500017)
- Dystonia (HP:0001332): An abnormally increased muscular tone that causes fixed abnormal postures. There is a slow, intermittent twisting motion that leads to exaggerated turning and posture of the extremities and trunk. Evidence: TAS. (OMIM:500017)
- Nystagmus (HP:0000639): Rhythmic, involuntary oscillations of one or both eyes related to abnormality in fixation, conjugate gaze, or vestibular mechanisms. Evidence: TAS. (OMIM:500017)
- Global developmental delay (HP:0001263): A delay in the achievement of motor or mental milestones in the domains of development of a child, including motor skills, speech and language, cognitive skills, and social and emotional skills. This term should only be used to describe children younger than five years of age. Evidence: TAS. (OMIM:500017)
- Hypotonia (HP:0001252): Hypotonia is an abnormally low muscle tone (the amount of tension or resistance to movement in a muscle). Even when relaxed, muscles have a continuous and passive partial contraction which provides some resistance to passive stretching. Hypotonia thus manifests as diminished resistance to passive stretching. Hypotonia is not the same as muscle weakness, although the two conditions can co-exist. Evidence: TAS. (OMIM:500017)
- Increased circulating lactate concentration (HP:0002151): Abnormally increased level of blood lactate (2-hydroxypropanoic acid). Lactate is produced from pyruvate by lactate dehydrogenase during normal metabolism. The terms lactate and lactic acid are often used interchangeably but lactate (the component measured in blood) is strictly a weak base whereas lactic acid is the corresponding acid. Lactic acidosis is often used clinically to describe elevated lactate but should be reserved for cases where there is a corresponding acidosis (pH below 7.35). Evidence: TAS. (OMIM:500017)
- Ataxia (HP:0001251): Ataxia refers to impaired coordination of voluntary muscle movement. Cerebellar ataxia refers to ataxia due to dysfunction of the cerebellum. This causes a variety of elementary neurological deficits including asynergy (lack of coordination between muscles, limbs and joints), dysmetria (lack of ability to judge distances that can lead to under- or overshoot in grasping movements), and dysdiadochokinesia (inability to perform rapid movements requiring antagonizing muscle groups to be switched on and off repeatedly). Evidence: TAS. (OMIM:500017)
- Mitochondrial inheritance (HP:0001427): A mode of inheritance that is observed for traits related to a gene encoded on the mitochondrial genome. Because the mitochondrial genome is essentially always maternally inherited, a mitochondrial condition can only be transmitted by females, although the condition can affect both sexes. The proportion of mutant mitochondria can vary (heteroplasmy). Evidence: TAS. (OMIM:500017)
- Decreased activity of mitochondrial respiratory chain (HP:0008972): Decreased activity of the mitochondrial respiratory chain. Evidence: TAS. (OMIM:500017)
- Optic atrophy (HP:0000648): Atrophy of the optic nerve. Optic atrophy results from the death of the retinal ganglion cell axons that comprise the optic nerve and manifesting as a pale optic nerve on fundoscopy. Evidence: TAS. (OMIM:500017)